- Bronchoconstriction (HP:4000007): Tightening of smooth muscle surrounding the bronchi and bronchioles with consequent wheezing and shortness of breath. Evidence: TAS. Frequency: Very rare (HP:0040284). (ORPHA:100081)
- Carcinoid tumor (HP:0100570): A tumor formed from the endocrine (argentaffin) cells of the mucosal lining of a variety of organs including the stomach and intestine. These cells are from neuroectodermal origin. Evidence: TAS. Frequency: Obligate (HP:0040280). (ORPHA:100081)
- Weight loss (HP:0001824): Reduction of total body weight. Evidence: TAS. Frequency: Frequent (HP:0040282). (ORPHA:100081)
- Constipation (HP:0002019): Infrequent or difficult evacuation of feces. Evidence: TAS. Frequency: Frequent (HP:0040282). (ORPHA:100081)
- Abdominal pain (HP:0002027): An unpleasant sensation characterized by physical discomfort (such as pricking, throbbing, or aching) and perceived to originate in the abdomen. Evidence: TAS. Frequency: Frequent (HP:0040282). (ORPHA:100081)
- Anorexia (HP:0002039): Lack of desire to eat (loss of appetite). Evidence: TAS. Frequency: Frequent (HP:0040282). (ORPHA:100081)
- Hematochezia (HP:0002573): The passage of fresh (red) blood per anus, usually in or with stools. Most rectal bleeding comes from the colon, rectum, or anus. Evidence: TAS. Frequency: Frequent (HP:0040282). (ORPHA:100081)
- Tenesmus (HP:0012702): A repeated, painful urge to defecate without excreting stool. Evidence: TAS. Frequency: Frequent (HP:0040282). (ORPHA:100081)
- Bloody diarrhea (HP:0025085): Passage of many stools containing blood. Evidence: TAS. Frequency: Frequent (HP:0040282). (ORPHA:100081)
- Hypoactive bowel sounds (HP:0030144): An decreased amount of bowel sounds. Evidence: TAS. Frequency: Frequent (HP:0040282). (ORPHA:100081)
- Atypical pulmonary carcinoid tumor (HP:0030446). Evidence: TAS. Frequency: Frequent (HP:0040282). (ORPHA:100081)
- Hepatomegaly (HP:0002240): Abnormally increased size of the liver. Evidence: TAS. Frequency: Occasional (HP:0040283). (ORPHA:100081)
- Melena (HP:0002249): The passage of blackish, tarry feces associated with gastrointestinal hemorrhage. Melena occurs if the blood remains in the colon long enough for it to be broken down by colonic bacteria. One degradation product, hematin, imbues the stool with a blackish color. Thus, melena generally occurs with bleeding from the upper gastrointestinal tract (e.g., stomach ulcers or duodenal ulcers), since the blood usually remains in the gut for a longer period of time than with lower gastrointestinal bleeding. Evidence: TAS. Frequency: Occasional (HP:0040283). (ORPHA:100081)
- Chronic noninfectious lymphadenopathy (HP:0002730): A chronic form of lymphadenopathy that is not related to infection. Evidence: TAS. Frequency: Occasional (HP:0040283). (ORPHA:100081)
- Elevated circulating hepatic transaminase concentration (HP:0002910): Elevations of the levels of SGOT and SGPT in the serum. SGOT (serum glutamic oxaloacetic transaminase) and SGPT (serum glutamic pyruvic transaminase) are transaminases primarily found in the liver and heart and are released into the bloodstream as the result of liver or heart damage. SGOT and SGPT are used clinically mainly as markers of liver damage. Evidence: TAS. Frequency: Occasional (HP:0040283). (ORPHA:100081)
- Right ventricular failure (HP:0001708): Reduced ability of the right ventricle to perform its function (to receive blood from the right atrium and to eject blood into the pulmonary artery), often leading to pitting peripheral edema, ascites, and hepatomegaly. Evidence: TAS. Frequency: Very rare (HP:0040284). (ORPHA:100081)
- Palpitations (HP:0001962): A sensation that the heart is pounding or racing, which is a non-specific sign but may be a manifestation of arrhythmia. Evidence: TAS. Frequency: Very rare (HP:0040284). (ORPHA:100081)
- Hypotension (HP:0002615): Low Blood Pressure, vascular hypotension. Evidence: TAS. Frequency: Very rare (HP:0040284). (ORPHA:100081)
- Increased serum serotonin (HP:0003144): A increased concentration of serotonin in the blood. Evidence: TAS. Frequency: Very rare (HP:0040284). (ORPHA:100081)
- Protracted diarrhea (HP:0004385). Evidence: TAS. Frequency: Very rare (HP:0040284). (ORPHA:100081)
- Tricuspid regurgitation (HP:0005180): Failure of the tricuspid valve to close sufficiently upon contraction of the right ventricle, causing blood to regurgitate (flow backward) into the right atrium. Evidence: TAS. Frequency: Very rare (HP:0040284). (ORPHA:100081)
- Facial telangiectasia (HP:0007380): Telangiectases (small dilated blood vessels) located near the surface of the skin of the face. Evidence: TAS. Frequency: Very rare (HP:0040284). (ORPHA:100081)
- Bowel urgency (HP:0012701): A sudden, irresistible need to have a bowel movement. Evidence: TAS. Frequency: Very rare (HP:0040284). (ORPHA:100081)
- Lack of bowel sounds (HP:0030145): Complete lack of abdominal sounds as assayed by examination of the abdomen with a stethoscope. Evidence: TAS. Frequency: Very rare (HP:0040284). (ORPHA:100081)
- Abnormal pulmonary valve cusp morphology (HP:0031566): Any structural anomaly of the pulmonary valve leaflets. Evidence: TAS. Frequency: Very rare (HP:0040284). (ORPHA:100081)
These phenotypes are associated with the disease Neuroendocrine tumor of the rectum (ORPHA:100081).